Phenotypes associated with the disease dystonia 35, childhood-onset (OMIM:619921):
- Dystonia (HP:0001332): An abnormally increased muscular tone that causes fixed abnormal postures. There is a slow, intermittent twisting motion that leads to exaggerated turning and posture of the extremities and trunk. Evidence: PCS. Frequency: 2/2. Onset: Infantile onset (HP:0003593). (PMID:34542157)
- Global developmental delay (HP:0001263): A delay in the achievement of motor or mental milestones in the domains of development of a child, including motor skills, speech and language, cognitive skills, and social and emotional skills. This term should only be used to describe children younger than five years of age. Evidence: PCS. Frequency: 0/2. (PMID:34542157)
- Infantile onset (HP:0003593): Onset of signs or symptoms of disease between 28 days to one year of life. Evidence: PCS. Frequency: 2/2. (PMID:34542157)
- Autosomal recessive inheritance (HP:0000007): A mode of inheritance that is observed for traits related to a gene encoded on one of the autosomes (i.e., the human chromosomes 1-22) in which a trait manifests in individuals with two pathogenic alleles, either homozygotes (two copies of the same mutant allele) or compound heterozygotes (whereby each copy of a gene has a distinct mutant allele). Evidence: PCS. (PMID:34542157)
- Intellectual disability (HP:0001249): The term intellectual disability or intellectual developmental disorder is used to describe significantly sub-average intellectual and adaptive functioning based on clinical assessment and as measured by individually administered, appropriately normed, standardized and validated tests of intellectual functioning and adaptive behavior, with onset during the developmental period from infancy through adolescence. Evidence: PCS. Frequency: 0/2. (PMID:34542157)